Phenotypes associated with the disease osteoarthritis susceptibility 3 (OMIM:607850):
- Joint stiffness (HP:0001387): Joint stiffness is a perceived sensation of tightness in a joint or joints when attempting to move them after a period of inactivity. Joint stiffness typically subsides over time. Evidence: TAS. (OMIM:607850)
- Arthralgia (HP:0002829): Joint pain. Evidence: TAS. (OMIM:607850)
- Osteoarthritis of the distal interphalangeal joint (HP:0006233). Evidence: TAS. (OMIM:607850)
- Osteoarthritis (HP:0002758): Degeneration (wear and tear) of articular cartilage, i.e., of the joint surface. Joint degeneration may be accompanied by osteophytes (bone overgrowth), narrowing of the joint space, regions of sclerosis at the joint surface, or joint deformity. Evidence: TAS. (OMIM:607850)
- Osteoarthritis of the first carpometacarpal joint (HP:0006226). Evidence: TAS. (OMIM:607850)
- Autosomal dominant inheritance (HP:0000006): A mode of inheritance that is observed for traits related to a gene encoded on one of the autosomes (i.e., the human chromosomes 1-22) in which a trait manifests in heterozygotes. In the context of medical genetics, an autosomal dominant disorder is caused when a single copy of the mutant allele is present. Males and females are affected equally, and can both transmit the disorder with a risk of 50% for each child of inheriting the mutant allele. Evidence: TAS. (OMIM:607850)